- Episodic ataxia (HP:0002131): Periodic spells of incoordination and imbalance, that is, episodes of ataxia typically lasting from 10 minutes to several hours or days. Evidence: TAS. Frequency: Obligate (HP:0040280). (ORPHA:79135)
- Vertigo (HP:0002321): An abnormal sensation of spinning while the body is actually stationary. Evidence: TAS. Frequency: Obligate (HP:0040280). (ORPHA:79135)
- Tinnitus (HP:0000360): Tinnitus is an auditory perception that can be described as the experience of sound, in the ear or in the head, in the absence of external acoustic stimulation. Evidence: TAS. Frequency: Frequent (HP:0040282). (ORPHA:79135)
- Myokymia (HP:0002411): Myokymia consists of involuntary, fine, continuous, undulating contractions that spread across the affected striated muscle. Evidence: TAS. Frequency: Frequent (HP:0040282). (ORPHA:79135)
- Nystagmus (HP:0000639): Rhythmic, involuntary oscillations of one or both eyes related to abnormality in fixation, conjugate gaze, or vestibular mechanisms. Evidence: TAS. Frequency: Occasional (HP:0040283). (ORPHA:79135)
- Seizure (HP:0001250): A seizure is an intermittent abnormality of nervous system physiology characterized by a transient occurrence of signs and/or symptoms due to abnormal excessive or synchronous neuronal activity in the brain. Evidence: TAS. Frequency: Occasional (HP:0040283). (ORPHA:79135)
- Hemiplegia (HP:0002301): Paralysis (complete loss of muscle function) in the arm, leg, and in some cases the face on one side of the body. Evidence: TAS. Frequency: Occasional (HP:0040283). (ORPHA:79135)
These phenotypes are associated with the disease Episodic ataxia type 3 (ORPHA:79135).